Phenotypes associated with the disease Frontal encephalocele (ORPHA:1931):
- Hydrocephalus (HP:0000238): Hydrocephalus is an active distension of the ventricular system of the brain resulting from inadequate passage of CSF from its point of production within the cerebral ventricles to its point of absorption into the systemic circulation. Evidence: TAS. Frequency: Frequent (HP:0040282). (ORPHA:1931)
- Macrocephaly (HP:0000256): Occipitofrontal (head) circumference greater than 97th centile compared to appropriate, age matched, sex-matched normal standards. Alternatively, a apparently increased size of the cranium. Evidence: TAS. Frequency: Very frequent (HP:0040281). (ORPHA:1931)
- Dolichocephaly (HP:0000268): An abnormality of skull shape characterized by a increased anterior-posterior diameter, i.e., an increased antero-posterior dimension of the skull. Cephalic index less than 76%. Alternatively, an apparently increased antero-posterior length of the head compared to width. Often due to premature closure of the sagittal suture. Evidence: TAS. Frequency: Occasional (HP:0040283). (ORPHA:1931)
- Hypertelorism (HP:0000316): Interpupillary distance more than 2 SD above the mean (alternatively, the appearance of an increased interpupillary distance or widely spaced eyes). Evidence: TAS. Frequency: Occasional (HP:0040283). (ORPHA:1931)
- Seizure (HP:0001250): A seizure is an intermittent abnormality of nervous system physiology characterized by a transient occurrence of signs and/or symptoms due to abnormal excessive or synchronous neuronal activity in the brain. Evidence: TAS. Frequency: Occasional (HP:0040283). (ORPHA:1931)
- Calvarial skull defect (HP:0001362): A localized defect in the bone of the skull resulting from abnormal embryological development. The defect is covered by normal skin. In some cases, skull x-rays have shown underlying lytic bone lesions which have closed before the age of one year. Evidence: TAS. Frequency: Frequent (HP:0040282). (ORPHA:1931)
- Encephalocele (HP:0002084): A neural tube defect characterized by sac-like protrusions of the brain and the membranes that cover it through openings in the skull. Evidence: TAS. Frequency: Very frequent (HP:0040281). (ORPHA:1931)
- Spina bifida (HP:0002414): Incomplete closure of the embryonic neural tube, whereby some vertebral arches remain unfused and open. The mildest form is spina bifida occulta, followed by meningocele and meningomyelocele. Evidence: TAS. Frequency: Frequent (HP:0040282). (ORPHA:1931)
- Leukodystrophy (HP:0002415): Leukodystrophy refers to deterioration of white matter of the brain resulting from degeneration of myelin sheaths in the CNS. Their basic defect is directly related to the synthesis and maintenance of myelin membranes. Symmetric white matter involvement at MRI is a typical finding in patients with leukodystrophies. Evidence: TAS. Frequency: Frequent (HP:0040282). (ORPHA:1931)
- Cerebral calcification (HP:0002514): The presence of calcium deposition within the cerebrum. Evidence: TAS. Frequency: Occasional (HP:0040283). (ORPHA:1931)
- Aplasia/Hypoplasia of the corpus callosum (HP:0007370): Absence or underdevelopment of the corpus callosum. Evidence: TAS. Frequency: Occasional (HP:0040283). (ORPHA:1931)